Phenotypes associated with the disease NUT midline carcinoma (ORPHA:443167):
- Neoplasm (HP:0002664): An organ or organ-system abnormality that consists of uncontrolled autonomous cell-proliferation which can occur in any part of the body as a benign or malignant neoplasm (tumor). Evidence: TAS. Frequency: Very frequent (HP:0040281). (ORPHA:443167)
- Leukemia (HP:0001909): A cancer of the blood and bone marrow characterized by an abnormal proliferation of leukocytes. Evidence: TAS. Frequency: Frequent (HP:0040282). (ORPHA:443167)
- Squamous cell carcinoma (HP:0002860): The presence of squamous cell carcinoma of the skin. Evidence: TAS. Frequency: Frequent (HP:0040282). (ORPHA:443167)
- Neuroblastoma (HP:0003006): Neuroblastoma is a solid tumor that originate in neural crest cells of the sympathetic nervous system. Most neuroblastomas originate in the abdomen, and most abdominal neuroblastomas originate in the adrenal gland. Neuroblastomas can also originate in the thorax, usually in the posterior mediastinum. Evidence: TAS. Frequency: Frequent (HP:0040282). (ORPHA:443167)
- Oropharyngeal squamous cell carcinoma (HP:0012182): A squamous cell carcinoma that originates in the oropharnyx. Evidence: TAS. Frequency: Frequent (HP:0040282). (ORPHA:443167)
- Ewing sarcoma (HP:0012254): A malignant tumor of the bone which always arises in the medullary tissue, occurring more often in cylindrical bones. Evidence: TAS. Frequency: Frequent (HP:0040282). (ORPHA:443167)
- Abnormal mediastinum morphology (HP:0045026): Any structural anomaly of the central compartment of the thoracic cavity. Evidence: TAS. Frequency: Frequent (HP:0040282). (ORPHA:443167)
- Pancreatoblastoma (HP:0100757): A rare pediatric carcinoma of the pancreas. Evidence: TAS. Frequency: Frequent (HP:0040282). (ORPHA:443167)
- Pancreatic squamous cell carcinoma (HP:0012142): A subtype of ductal pancreatic carcinoma that is thought to originate from squamous metaplasia of pancreatic ductal epithelium. Evidence: TAS. Frequency: Occasional (HP:0040283). (ORPHA:443167)